Phenotypes associated with the disease congenital disorder of glycosylation, type IIcc (OMIM:621381):
- Inability to walk (HP:0002540): Incapability to ambulate. Evidence: PCS. Frequency: 2/5. (PMID:40267907)
- Strabismus (HP:0000486): A misalignment of the eyes so that the visual axes deviate from bifoveal fixation. The classification of strabismus may be based on a number of features including the relative position of the eyes, whether the deviation is latent or manifest, intermittent or constant, concomitant or otherwise and according to the age of onset and the relevance of any associated refractive error. Evidence: PCS. Frequency: 1/1. (PMID:40267907)
- Hearing impairment (HP:0000365): A decreased magnitude of the sensory perception of sound. Evidence: PCS. Frequency: 2/10. (PMID:40267907)
- Short stature (HP:0004322): A height below that which is expected according to age and gender norms. Although there is no universally accepted definition of short stature, many refer to "short stature" as height more than 2 standard deviations below the mean for age and gender (or below the 3rd percentile for age and gender dependent norms). Evidence: PCS. Frequency: 4/11. (PMID:40267907)
- Retinal coloboma (HP:0000480): A notch or cleft of the retina or choroid, located vertically below the optic disc. Evidence: PCS. Frequency: 1/1. (PMID:40267907)
- Focal impaired awareness seizure (HP:0002384): Focal impaired awareness seizure (or focal seizure with impaired or lost awareness) is a type of focal-onset seizure characterized by some degree (which may be partial) of impairment of the person's awareness of themselves or their surroundings at any point during the seizure. Evidence: PCS. Frequency: 1/1. (PMID:40267907)
- Unilateral cryptorchidism (HP:0012741): Absence of a testis from the scrotum on one side owing to failure of the testis or testes to descend through the inguinal canal to the scrotum. Evidence: PCS. Frequency: 1/1. (PMID:40267907)
- Thin corpus callosum (HP:0033725): An abnormally thin corpus callous, due to atrophy, hypoplasia or agenesis. This term is intended to be used in situations where it is not known if thinning of the corpus callosum (for instance, as visualized by magnetic resonance tomography) is due to abnormal development (e.g. a leukodystrophy) or atrophy following normal development (e.g. neurodegeneration). Evidence: PCS. Frequency: 6/9. (PMID:40267907)
- Nystagmus (HP:0000639): Rhythmic, involuntary oscillations of one or both eyes related to abnormality in fixation, conjugate gaze, or vestibular mechanisms. Evidence: PCS. Frequency: 1/8. (PMID:40267907)
- Hemivertebrae (HP:0002937): Absence of one half of the vertebral body. Evidence: PCS. Frequency: 0/10. (PMID:40267907)
- Overlapping toe (HP:0001845): Describes a foot digit resting on the dorsal surface of an adjacent digit when the foot is at rest. Initially clawing may be dynamic and only noticeable on walking. Over time the plantar plate tears, subluxation occurs at the metatarsophalangeal joint (MTPJ), and the deformity becomes permanent. Evidence: PCS. Frequency: 1/1. (PMID:40267907)
- Hyperactivity (HP:0000752): Hyperactivity is a condition characterized by constant and unusually high levels of activity, even in situations where it is deemed inappropriate. Evidence: PCS. Frequency: 3/3. (PMID:40267907)
- Posteriorly rotated ears (HP:0000358): A type of abnormal location of the ears in which the position of the ears is characterized by posterior rotation (the superior part of the ears is rotated towards the back of the head, and the inferior part of the ears towards the front). Evidence: PCS. Frequency: 1/1. (PMID:40267907)
- Neonatal onset (HP:0003623): Onset of signs or symptoms of disease within the first 28 days of life. Evidence: PCS. Frequency: 3/5. (PMID:40267907)
- Absent speech (HP:0001344): Complete lack of development of speech and language abilities. Evidence: PCS. Frequency: 7/7. (PMID:40267907)
- Interictal EEG abnormality (HP:0025373): Interictal refers to a period of time between epileptic seizures. Electroencephalographic (EEG) patterns are important in the differential diagnosis of epilepsy, and the EEG is almost always abnormal during a seizure. Some persons with seizures may show EEG abnormalities between seizures, while others do not. In some cases, multiple interictal EEGs must be recorded before an abnormality is observed. In most cases the electrographic pattern of seizure onset is completely different from the activity recorded during interictal discharge. Evidence: PCS. Frequency: 5/7. (PMID:40267907)
- Babinski sign (HP:0003487): Upturning of the big toe (and sometimes fanning of the other toes) in response to stimulation of the sole of the foot. If the Babinski sign is present it can indicate damage to the corticospinal tract. Evidence: PCS. Frequency: 3/6. (PMID:40267907)
- Cerebral palsy (HP:0100021): Cerebral palsy describes a group of permanent disorders of the development of movement and posture, causing activity limitation, that are attributed to nonprogressive disturbances that occurred in the developing fetal or infant brain. The motor disorders of cerebral palsy are often accompanied by disturbances of sensation, perception, cognition, communication, and behavior, by epilepsy, and by secondary musculoskeletal problems. Evidence: PCS. Frequency: 1/1. (PMID:40267907)
- Overlapping fingers (HP:0010557): A finger resting on the dorsal surface of an adjacent digit when the hand is at rest. Evidence: PCS. Frequency: 1/11. (PMID:40267907)
- Recurrent hand flapping (HP:0100023): A type of repetitive behavior in which the affected individual repeatedly waves the hands and/or arms rhythmically. Evidence: PCS. Frequency: 1/1. (PMID:40267907)
- Knee contracture (HP:0034671): Lack of full passive range of motion (restrictions in flexion, extension, or other movements) of the knee joint resulting from structural changes of non-bony tissues, such as muscles, tendons, ligaments, joint capsules and/or skin. Evidence: PCS. Frequency: 1/2. (PMID:40267907)
- Cystic renal dysplasia (HP:0000800). Evidence: PCS. Frequency: 1/1. (PMID:40267907)
- Autosomal recessive inheritance (HP:0000007): A mode of inheritance that is observed for traits related to a gene encoded on one of the autosomes (i.e., the human chromosomes 1-22) in which a trait manifests in individuals with two pathogenic alleles, either homozygotes (two copies of the same mutant allele) or compound heterozygotes (whereby each copy of a gene has a distinct mutant allele). Evidence: PCS. (PMID:40267907)
- Drooling (HP:0002307): Habitual flow of saliva out of the mouth. Evidence: PCS. Frequency: 3/3. (PMID:40267907)
- Sandal gap (HP:0001852): A widely spaced gap between the first toe (the great toe) and the second toe. Evidence: PCS. Frequency: 1/11. (PMID:40267907)
- Elbow contracture (HP:0034391): A limitation in the passive range of motion of the elbow resulting from loss of elasticity in the periarticular tissues owing to structural changes of non-bony tissues, such as muscles, tendons, ligaments, joint capsules or skin. Evidence: PCS. Frequency: 1/3. (PMID:40267907)
- Tremor (HP:0001337): An unintentional, oscillating to-and-fro muscle movement about a joint axis. Evidence: PCS. Frequency: 1/1. (PMID:40267907)
- Myoclonus (HP:0001336): Very brief, involuntary random muscular contractions occurring at rest, in response to sensory stimuli, or accompanying voluntary movements. Evidence: PCS. Frequency: 1/1. (PMID:40267907)
- Hydronephrosis (HP:0000126): Severe distention of the kidney with dilation of the renal pelvis and calices. Evidence: PCS. Frequency: 1/1. (PMID:40267907)
- Hypertonia (HP:0001276): A condition in which there is increased muscle tone so that arms or legs, for example, are stiff and difficult to move. Evidence: PCS. Frequency: 2/6. (PMID:40267907)
- Upslanted palpebral fissure (HP:0000582): The palpebral fissure inclination is more than two standard deviations above the mean for age (objective); or, the inclination of the palpebral fissure is greater than typical for age. Evidence: PCS. Frequency: 1/1. (PMID:40267907)
- Sloping forehead (HP:0000340): Inclination of the anterior surface of the forehead from the vertical more than two standard deviations above the mean (objective); or apparently excessive posterior sloping of the forehead in a lateral view. Evidence: PCS. Frequency: 1/1. (PMID:40267907)
- Congenital onset (HP:0003577): A phenotypic abnormality that is present at birth. Evidence: PCS. Frequency: 2/5. (PMID:40267907)
- Long philtrum (HP:0000343): Distance between nasal base and midline upper lip vermilion border more than 2 SD above the mean. Alternatively, an apparently increased distance between nasal base and midline upper lip vermilion border. Evidence: PCS. Frequency: 2/2. (PMID:40267907)
- Pulmonary hypoplasia (HP:0002089). Evidence: PCS. Frequency: 1/1. (PMID:40267907)
- Ambiguous genitalia (HP:0000062): A genital phenotype that is not clearly assignable to a single gender. Ambiguous genitalia can be evaluated using the Prader scale: Prader 0: Normal female external genitalia. Prader 1: Female external genitalia with clitoromegaly. Prader 2: Clitoromegaly with partial labial fusion forming a funnel-shaped urogenital sinus. Prader 3: Increased phallic enlargement. Complete labioscrotal fusion forming a urogenital sinus with a single opening. Prader 4: Complete scrotal fusion with urogenital opening at the base or on the shaft of the phallus. Prader 5: Normal male external genitalia. The diagnosis of ambiguous genitalia is made for Prader 1-4. Evidence: PCS. Frequency: 1/1. (PMID:40267907)
- Sleep disturbance (HP:0002360): An abnormal pattern in the quality, quantity, or characteristics of sleep. Evidence: PCS. Frequency: 2/2. (PMID:40267907)
- Hepatic fibrosis (HP:0001395): The presence of excessive fibrous connective tissue in the liver. Fibrosis is a reparative or reactive process. Evidence: PCS. Frequency: 1/11. (PMID:40267907)
- Hepatomegaly (HP:0002240): Abnormally increased size of the liver. Evidence: PCS. Frequency: 1/11. (PMID:40267907)
- Hernia (HP:0100790). Evidence: PCS. Frequency: 1/1. (PMID:40267907)
- Echogenic fetal bowel (HP:0010943): Echogenic bowel is defined as fetal bowel with homogenous areas of echogenicity that are equal to or greater than that of surrounding bone. Evidence: PCS. Frequency: 1/1. (PMID:40267907)
- Cerebral visual impairment (HP:0100704): A form of loss of vision caused by damage to the visual cortex rather than a defect in the eye. Evidence: PCS. Frequency: 1/9. (PMID:40267907)
- Irritability (HP:0000737): An emotional state characterized by negative feelings of heightened frustration, annoyance, or feeling upset, often triggered by internal factors (e.g., fatigue, hunger, unfulfilled desires) or external factors (e.g., social or environmental challenges). Irritability may be unpredictable, and is accompanied by a lowered threshold for emotional reactivity and observable features (speech, facial expressions, or psychomotor activity). Evidence: PCS. Frequency: 1/1. (PMID:40267907)
- Anxiety (HP:0000739): Intense feelings of nervousness, tension, or panic often arise in response to interpersonal stresses. There is worry about the negative effects of past unpleasant experiences and future negative possibilities. Individuals may feel fearful, apprehensive, or threatened by uncertainty, and they may also have fears of falling apart or losing control. Evidence: PCS. Frequency: 1/1. (PMID:40267907)
- Transposition of the great arteries (HP:0001669): A complex congenital heart defect in which the aorta arises from the morphologic right ventricle and the pulmonary artery arises from the morphologic left ventricle. Evidence: PCS. Frequency: 1/1. (PMID:40267907)
- Clonic seizure (HP:0020221): A clonic seizure is a type of motor seizure characterized by sustained rhythmic jerking, that is regularly repetitive. Evidence: PCS. Frequency: 4/4. (PMID:40267907)
- Motor stereotypy (HP:0000733): Use of the same abnormal action in response to certain triggers or at random. They may be used as a way to regulate one's internal state but must otherwise have no apparent functional purpose. Evidence: PCS. Frequency: 2/2. (PMID:40267907)
- Iris coloboma (HP:0000612): A coloboma of the iris. Evidence: PCS. Frequency: 1/1. (PMID:40267907)
- Thin upper lip vermilion (HP:0000219): Height of the vermilion of the upper lip in the midline more than 2 SD below the mean. Alternatively, an apparently reduced height of the vermilion of the upper lip in the frontal view (subjective). Evidence: PCS. Frequency: 1/1. (PMID:40267907)
- Clinodactyly (HP:0030084): An angulation of a digit at an interphalangeal joint in the plane of the palm (finger) or sole (toe). Evidence: PCS. Frequency: 1/1. (PMID:40267907)
- Oligohydramnios (HP:0001562): Diminished amniotic fluid volume in pregnancy. Evidence: PCS. Frequency: 1/1. (PMID:40267907)
- Torticollis (HP:0000473): Involuntary contractions of the neck musculature resulting in an abnormal posture of or abnormal movements of the head. Evidence: PCS. Frequency: 1/1. (PMID:40267907)
- Arachnodactyly (HP:0001166): Abnormally long and slender fingers (spider fingers). Evidence: PCS. Frequency: 3/11. (PMID:40267907)
- Scoliosis (HP:0002650): The presence of an abnormal lateral curvature of the spine. Evidence: PCS. Frequency: 1/11. (PMID:40267907)
- Delayed speech and language development (HP:0000750): A degree of language development that is significantly below the norm for a child of a specified age. Evidence: PCS. Frequency: 3/3. (PMID:40267907)
- Status epilepticus (HP:0002133): Status epilepticus is a type of prolonged seizure resulting either from the failure of the mechanisms responsible for seizure termination or from the initiation of mechanisms which lead to abnormally prolonged seizures (after time point t1). It is a condition that can have long-term consequences (after time point t2), including neuronal death, neuronal injury, and alteration of neuronal networks, depending on the type and duration of seizures. Evidence: PCS. Frequency: 1/1. (PMID:40267907)
- Febrile seizure (within the age range of 3 months to 6 years) (HP:0002373): A febrile seizure is any type of seizure (most often a generalized tonic-clonic seizure) occurring with fever (at least 38 degrees Celsius) but in the absence of central nervous system infection, severe metabolic disturbance or other alternative precipitant in children between the ages of 3 months and 6 years. Evidence: PCS. Frequency: 3/3. (PMID:40267907)
- Secondary microcephaly (HP:0005484): Head circumference which falls below 2 standard deviations below the mean for age and gender because of insufficient head growth after birth. Evidence: PCS. Frequency: 9/11. (PMID:40267907)
- Bilateral tonic-clonic seizure with generalized onset (HP:0025190): A bilateral tonic-clonic seizure with generalized onset is a type of bilateral tonic-clonic seizure characterized by generalized onset; these seizures rapidly engage networks in both hemispheres at the start of the seizure. Evidence: PCS. Frequency: 2/2. (PMID:40267907)
- Severe global developmental delay (HP:0011344): A severe delay in the achievement of motor or mental milestones in the domains of development of a child. Evidence: PCS. Frequency: 9/9. (PMID:40267907)
- Cyclically decreased total neutrophil count (HP:0040289): Abnormal decrease of the absolute number of neutrophils in the blood, per microlitre, compared to a reference range for a given sex and age-group, which occurs cyclically and then recovers without intervention. Evidence: PCS. Frequency: 1/1. (PMID:40267907)
- Double outlet right ventricle (HP:0001719): Double outlet right ventricle (DORV) is a type of ventriculoarterial connection in which both great vessels arise entirely or predominantly from the right ventricle. Evidence: PCS. Frequency: 1/1. (PMID:40267907)
- Tonic seizure (HP:0032792): A tonic seizure is a type of motor seizure characterized by unilateral or bilateral limb stiffening or elevation, often with neck stiffening. Evidence: PCS. Frequency: 2/2. (PMID:40267907)
- High forehead (HP:0000348): An abnormally increased height of the forehead. Evidence: PCS. Frequency: 3/3. (PMID:40267907)
- Self-injurious behavior (HP:0100716): Self-aggression. Evidence: PCS. Frequency: 2/2. (PMID:40267907)
- Thoracic hemivertebrae (HP:0008467): Absence of one half of the vertebral body in the thoracic spine. Evidence: PCS. Frequency: 1/1. (PMID:40267907)
- Syndactyly (HP:0001159): Webbing or fusion of the fingers or toes, involving soft parts only or including bone structure. Bony fusions are referred to as "bony" syndactyly if the fusion occurs in a radio-ulnar axis. Fusions of bones of the fingers or toes in a proximo-distal axis are referred to as "symphalangism". Evidence: PCS. Frequency: 1/1. (PMID:40267907)
- Attention deficit hyperactivity disorder (HP:0007018): Attention deficit hyperactivity disorder (ADHD) manifests at age 2-3 years or by first grade at the latest. The main symptoms are distractibility, impulsivity, hyperactivity, and often trouble organizing tasks and projects, difficulty going to sleep, and social problems from being aggressive, loud, or impatient. Evidence: PCS. Frequency: 2/2. (PMID:40267907)
- Neonatal respiratory distress (HP:0002643): Respiratory difficulty as newborn. Evidence: PCS. Frequency: 3/3. (PMID:40267907)
- Micrognathia (HP:0000347): Developmental hypoplasia of the mandible. Evidence: PCS. Frequency: 2/2. (PMID:40267907)
- Coloboma (HP:0000589): A developmental defect characterized by a cleft of some portion of the eye or ocular adnexa. Evidence: PCS. Frequency: 0/8. (PMID:40267907)
- Optic disc coloboma (HP:0000588): A cleft of the optic nerve that extends inferiorly. Evidence: PCS. Frequency: 1/1. (PMID:40267907)
- Bilateral tonic-clonic seizure (HP:0002069): A bilateral tonic-clonic seizure is a seizure defined by a tonic (bilateral increased tone, lasting seconds to minutes) and then a clonic (bilateral sustained rhythmic jerking) phase. Evidence: PCS. Frequency: 2/2. (PMID:40267907)
- Delayed CNS myelination (HP:0002188): Delayed myelination in the central nervous system. Evidence: PCS. Frequency: 2/5. (PMID:40267907)
- Seizure (HP:0001250): A seizure is an intermittent abnormality of nervous system physiology characterized by a transient occurrence of signs and/or symptoms due to abnormal excessive or synchronous neuronal activity in the brain. Evidence: PCS. Frequency: 1/4. (PMID:40267907)
- Hypotonia (HP:0001252): Hypotonia is an abnormally low muscle tone (the amount of tension or resistance to movement in a muscle). Even when relaxed, muscles have a continuous and passive partial contraction which provides some resistance to passive stretching. Hypotonia thus manifests as diminished resistance to passive stretching. Hypotonia is not the same as muscle weakness, although the two conditions can co-exist. Evidence: PCS. Frequency: 4/10. (PMID:40267907)
- Lower limb spasticity (HP:0002061): Spasticity (velocity-dependent increase in tonic stretch reflexes with increased muscle tone and hyperexcitable tendon reflexes) in the muscles of the lower limbs, hips, and pelvis. Evidence: PCS. Frequency: 1/1. (PMID:40267907)
- Coarse facial features (HP:0000280): Absence of fine and sharp appearance of brows, nose, lips, mouth, and chin, usually because of rounded and heavy features or thickened skin with or without thickening of subcutaneous and bony tissues. Evidence: PCS. Frequency: 4/4. (PMID:40267907)
- Hypoplastic aortic arch (HP:0012304): Underdevelopment of the arch of aorta. Evidence: PCS. Frequency: 1/1. (PMID:40267907)
- Moderate global developmental delay (HP:0011343): A moderate delay in the achievement of motor or mental milestones in the domains of development of a child. Evidence: PCS. Frequency: 2/2. (PMID:40267907)
- Smooth philtrum (HP:0000319): Flat skin surface, with no ridge formation in the central region of the upper lip between the nasal base and upper vermilion border. Evidence: PCS. Frequency: 4/4. (PMID:40267907)
- Autism (HP:0000717): Autism is a neurodevelopmental disorder characterized by impaired social interaction and communication, and by restricted and repetitive behavior. Autism begins in childhood. It is marked by the presence of markedly abnormal or impaired development in social interaction and communication and a markedly restricted repertoire of activity and interest. Manifestations of the disorder vary greatly depending on the developmental level and chronological age of the individual (DSM-IV). Evidence: PCS. Frequency: 1/1. (PMID:40267907)
- Bicuspid aortic valve (HP:0001647): The presence of an aortic valve with two instead of the normal three cusps (flaps). Bicuspid aortic valvue is a malformation of a commissure (small space between the attachment of each cusp to the aortic wall) and the adjacent parts of the two corresponding cusps forming a raphe (the fused area of the two underdeveloped cusps turning into a malformed commissure between both cusps; the raphe is a fibrous ridge that extends from the commissure to the free edge of the two underdeveloped, conjoint cusps). Evidence: PCS. Frequency: 1/1. (PMID:40267907)
- Hypertelorism (HP:0000316): Interpupillary distance more than 2 SD above the mean (alternatively, the appearance of an increased interpupillary distance or widely spaced eyes). Evidence: PCS. Frequency: 1/1. (PMID:40267907)
- Patent ductus arteriosus (HP:0001643): In utero, the ductus arteriosus (DA) serves to divert ventricular output away from the lungs and toward the placenta by connecting the main pulmonary artery to the descending aorta. A patent ductus arteriosus (PDA) in the first 3 days of life is a physiologic shunt in healthy term and preterm newborn infants, and normally is substantially closed within about 24 hours after bith and completely closed after about three weeks. Failure of physiologcal closure is referred to a persistent or patent ductus arteriosus (PDA). Depending on the degree of left-to-right shunting, PDA can have clinical consequences. Evidence: PCS. Frequency: 3/3. (PMID:40267907)
- Hirsutism (HP:0001007): Abnormally increased hair growth referring to a male pattern of body hair (androgenic hair). Evidence: PCS. Frequency: 3/3. (PMID:40267907)
- Central apnea (HP:0002871): Apnea resulting from depression of the respiratory centers in the medulla oblongata. There is a lack of respiratory effort rather than obstruction of airflow. Evidence: PCS. Frequency: 1/1. (PMID:40267907)
- Feeding difficulties (HP:0011968): Impaired ability to eat related to problems gathering food and getting ready to suck, chew, or swallow it. Evidence: PCS. Frequency: 3/10. (PMID:40267907)
- Global developmental delay (HP:0001263): A delay in the achievement of motor or mental milestones in the domains of development of a child, including motor skills, speech and language, cognitive skills, and social and emotional skills. This term should only be used to describe children younger than five years of age. Evidence: PCS. Frequency: 4/4. (PMID:40267907)
- Delayed gross motor development (HP:0002194): A type of motor delay characterized by a delay in acquiring the ability to control the large muscles of the body for walking, running, sitting, and crawling. Evidence: PCS. Frequency: 2/2. (PMID:40267907)
- Common atrium (HP:0011565): Complete absence of the interatrial septum with common atrioventricular valve and two atrioventricular connections. Evidence: PCS. Frequency: 1/1. (PMID:40267907)
- Abnormal isoelectric focusing of serum transferrin (HP:0003160): Glycosylated transferrin concentrations can be measured in serum as a marker of N-linked glycosylation fidelity. In the traditional nomenclature for congenital disorders of glycosylation, absence of entire glycans was designated type I, and loss of one or more monosaccharides as type II. These terms are retained for historical reasons but for new annotations the precise glycosylation defect should be recorded. Evidence: PCS. Frequency: 0/3. (PMID:40267907)
- Bilateral superior vena cava (HP:0033379): The presence of a left and a right superior vena cava. Evidence: PCS. Frequency: 1/1. (PMID:40267907)
- Bilateral cleft lip (HP:0100336): A non-midline cleft of the upper lip on the left and right sides. Evidence: PCS. Frequency: 1/1. (PMID:40267907)
- Increased nuchal translucency (HP:0010880): Nuchal translucency is the sonographic appearance of subcutaneous accumulation of liquid in the back of the fetal neck in the first trimester of pregnancy (11-14 gestational weeks of pregnancy). Evidence: PCS. Frequency: 1/1. (PMID:40267907)
- Autistic behavior (HP:0000729): Persistent deficits in social interaction and communication and interaction as well as a markedly restricted repertoire of activity and interest as well as repetitive patterns of behavior. Evidence: PCS. Frequency: 4/4. (PMID:40267907)
- Prominent nose (HP:0000448): Distance between subnasale and pronasale more than two standard deviations above the mean, or alternatively, an apparently increased anterior protrusion of the nasal tip. Evidence: PCS. Frequency: 2/2. (PMID:40267907)
- Cyanosis (HP:0000961): Bluish discoloration of the skin and mucosa due to poor circulation or inadequate oxygenation of arterial or capillary blood. Evidence: PCS. Frequency: 2/2. (PMID:40267907)
- Focal-onset seizure (HP:0007359): A focal-onset seizure is a type of seizure originating within networks limited to one hemisphere. They may be discretely localized or more widely distributed, and may originate in subcortical structures. Evidence: PCS. Frequency: 1/1. (PMID:40267907)
- Spasticity (HP:0001257): A motor disorder characterized by a velocity-dependent increase in tonic stretch reflexes with increased muscle tone, exaggerated (hyperexcitable) tendon reflexes. Evidence: PCS. Frequency: 1/1. (PMID:40267907)
- Short philtrum (HP:0000322): Distance between nasal base and midline upper lip vermilion border more than 2 SD below the mean. Alternatively, an apparently decreased distance between nasal base and midline upper lip vermilion border. Evidence: PCS. Frequency: 2/3. (PMID:40267907)
- Triangular face (HP:0000325): Facial contour, as viewed from the front, triangular in shape, with breadth at the temples and tapering to a narrow chin. Evidence: PCS. Frequency: 2/2. (PMID:40267907)
- Patent foramen ovale (HP:0001655): Failure of the foramen ovale to seal postnatally, leaving a potential conduit between the left and right cardiac atria. Evidence: PCS. Frequency: 1/1. (PMID:40267907)
- Clonus (HP:0002169): A series of rhythmic and involuntary muscle contractions (at a frequency of about 5 to 7 Hz) that occur in response to an abruptly applied and sustained stretch. Evidence: PCS. Frequency: 0/5. (PMID:40267907)
- Single umbilical artery (HP:0001195): Single umbilical artery (SUA) is the absence of one of the two umbilical arteries surrounding the fetal bladder and in the fetal umbilical cord. Evidence: PCS. Frequency: 1/1. (PMID:40267907)
- Gray matter heterotopia (HP:0002282): Heterotopia or neuronal heterotopia are macroscopic clusters of misplaced neurons (gray matter), most often situated along the ventricular walls or within the subcortical white matter. Evidence: PCS. Frequency: 2/5. (PMID:40267907)
- Intrahepatic bile duct dilatation (HP:0033149): Increased diameter (caliber) of intrahepatic bile ducts (bile ducts that transport bile between the Canals of Hering and the interlobar bile ducts). Evidence: PCS. Frequency: 1/11. (PMID:40267907)
- Severe intellectual disability (HP:0010864): Severe intellectual disability (ID) is defined as a type of ID characterized by severely sub-average adaptive functioning and intellectual functioning, with an intelligence quotient (IQ) the range of 20-34. Evidence: PCS. Frequency: 10/10. (PMID:40267907)
- Ventricular septal defect (HP:0001629): A hole between the two bottom chambers (ventricles) of the heart. The defect is centered around the most superior aspect of the ventricular septum. Evidence: PCS. Frequency: 2/2. (PMID:40267907)
- Reduced eye contact (HP:0000817): A reduced frequency or duration of eye contact. Evidence: PCS. Frequency: 1/9. (PMID:40267907)
- Mitral atresia (HP:0011560): A congenital defect with failure to open of the mitral valve orifice. Evidence: PCS. Frequency: 1/1. (PMID:40267907)
- Unsteady gait (HP:0002317). Evidence: PCS. Frequency: 1/5. (PMID:40267907)
- Aspiration (HP:0002835): Inspiration of a foreign object into the airway. Evidence: PCS. Frequency: 2/2. (PMID:40267907)
- Breech presentation (HP:0001623): A position of the fetus at delivery in which the fetus enters the birth canal with the buttocks or feet first. Evidence: PCS. Frequency: 2/2. (PMID:40267907)
- Brisk reflexes (HP:0001348): Tendon reflexes that are noticeably more active than usual (conventionally denoted 3+ on clinical examination). Brisk reflexes may or may not indicate a neurological lesion. They are distinguished from hyperreflexia by the fact that hyerreflexia is characterized by hyperactive repeating (clonic) reflexes, which are considered to be always abnormal. Evidence: PCS. Frequency: 5/9. (PMID:40267907)
- Wide nasal bridge (HP:0000431): Increased breadth of the nasal bridge (and with it, the nasal root). Evidence: PCS. Frequency: 1/1. (PMID:40267907)
- Delayed ability to walk (HP:0031936): A failure to achieve the ability to walk at an appropriate developmental stage. Most children learn to walk in a series of stages, and learn to walk short distances independently between 12 and 15 months. Evidence: PCS. Frequency: 8/10. (PMID:40267907)
- Long face (HP:0000276): Facial height (length) is more than 2 standard deviations above the mean (objective); or, an apparent increase in the height (length) of the face (subjective). Evidence: PCS. Frequency: 6/6. (PMID:40267907)
- Cardiomegaly (HP:0001640): Increased size of the heart, clinically defined as an increased transverse diameter of the cardiac silhouette that is greater than or equal to 50% of the transverse diameter of the chest (increased cardiothoracic ratio) on a posterior-anterior projection of a chest radiograph or a computed tomography. Evidence: PCS. Frequency: 1/1. (PMID:40267907)
- Short fetal femur length (HP:0011428): A short femur length is defined as either a measurement below the 2.5th percentile for gestational age or a measurement that is less than 0.9 of that predicted by the measured biparietal diameter. The femur should be measured with the bone perpendicular to the ultrasound beam and with epiphyseal cartilages visible but not included in the measurement (PMID:16100637). Evidence: PCS. Frequency: 1/1. (PMID:40267907)
- Persistent head lag (HP:0032988): The Premie-Neuro and the Dubowitz Neurological Examination score head lag in the same manner. Scoring for both is as follows: 0 = head drops and stays back, 1 = tries to lift head but drops it back, 2 = able to lift head slightly, 3 = lifts head in line with body, and 4 = head in front of body. This term applies if head lag persists beyond an expected age at a level of 0 or 1. Persistent head lag beyond age 4 mo has been linked to poor outcomes. Evidence: PCS. Frequency: 1/7. (PMID:40267907)
- Myoclonic absence seizure (HP:0011150): Myoclonic absence seizure is a type of generalized non-motor (absence) seizure characterized by an interruption of ongoing activities, a blank stare and rhythmic three-per-second myoclonic movements, causing ratcheting abduction of the upper limbs leading to progressive arm elevation, and associated with 3 Hz generalized spike-wave discharges on the electroencephalogram. Duration is typically 10-60 s. Whilst impairment of consciousness may not be obvious the ILAE classified this seizure as a generalized non-motor seizure in 2017. Evidence: PCS. Frequency: 1/1. (PMID:40267907)
- Increased hepatic echogenicity (HP:0031141): Increased echogenicity of liver tissue on sonography, manifested as an increased amount of white on the screen of the sonography device. Evidence: PCS. Frequency: 1/11. (PMID:40267907)
- Prominent nasal bridge (HP:0000426): Anterior positioning of the nasal root in comparison to the usual positioning for age. Evidence: PCS. Frequency: 3/3. (PMID:40267907)
- Hypothyroidism (HP:0000821): Deficiency of thyroid hormone. Evidence: PCS. Frequency: 1/1. (PMID:40267907)
- Tip-toe gait (HP:0030051): An abnormal gait pattern characterized by the failure of the heel to contact the floor at the onset of stance during gait. Evidence: PCS. Frequency: 1/4. (PMID:40267907)
- Atrial septal defect (HP:0001631): Atrial septal defect (ASD) is a congenital abnormality of the interatrial septum that enables blood flow between the left and right atria via the interatrial septum. Evidence: PCS. Frequency: 1/1. (PMID:40267907)
- Cryptorchidism (HP:0000028): Testis in inguinal canal. That is, absence of one or both testes from the scrotum owing to failure of the testis or testes to descend through the inguinal canal to the scrotum. Evidence: PCS. Frequency: 2/2. (PMID:40267907)
- Horizontal nystagmus (HP:0000666): Nystagmus consisting of horizontal to-and-fro eye movements. Evidence: PCS. Frequency: 1/2. (PMID:40267907)
- Decreased total neutrophil count (HP:0001875): Abnormal decrease of absolute number of neutrophils in the blood, per microlitre, compared to a reference range for a given sex and age-group. Evidence: PCS. Frequency: 1/10. (PMID:40267907)